- Short stature (HP:0004322): A height below that which is expected according to age and gender norms. Although there is no universally accepted definition of short stature, many refer to "short stature" as height more than 2 standard deviations below the mean for age and gender (or below the 3rd percentile for age and gender dependent norms). Evidence: IEA. (OMIM:208600)
- Asthma (HP:0002099): Asthma is characterized by increased responsiveness of the tracheobronchial tree to multiple stimuli, leading to narrowing of the air passages with resultant dyspnea, cough, and wheezing. Evidence: IEA. (OMIM:208600)
- Autosomal recessive inheritance (HP:0000007): A mode of inheritance that is observed for traits related to a gene encoded on one of the autosomes (i.e., the human chromosomes 1-22) in which a trait manifests in individuals with two pathogenic alleles, either homozygotes (two copies of the same mutant allele) or compound heterozygotes (whereby each copy of a gene has a distinct mutant allele). Evidence: IEA. (OMIM:208600)
- Increased circulating IgA concentration (HP:0003261): An abnormally increased level of immunoglobulin A in blood. Evidence: IEA. (OMIM:208600)
These phenotypes are associated with the disease asthma, short stature, and elevated IgA (OMIM:208600).